- Supranuclear gaze palsy (HP:0000605): A supranuclear gaze palsy is an inability to look in a particular direction as a result of cerebral impairment. There is a loss of the voluntary aspect of eye movements, but, as the brainstem is still intact, all the reflex conjugate eye movements are normal. Evidence: TAS. Frequency: Very frequent (HP:0040281). (ORPHA:683)
- Supranuclear ophthalmoplegia (HP:0000623): A vertical gaze palsy with inability to direct the gaze of the eyes downwards. Evidence: TAS. Frequency: Very frequent (HP:0040281). (ORPHA:683)
- Dysphagia (HP:0002015): Difficulty in swallowing. Evidence: TAS. Frequency: Very frequent (HP:0040281). (ORPHA:683)
- Postural instability (HP:0002172): A tendency to fall or the inability to keep oneself from falling; imbalance. The retropulsion test is widely regarded as the gold standard to evaluate postural instability, Use of the retropulsion test includes a rapid balance perturbation in the backward direction, and the number of balance correcting steps (or total absence thereof) is used to rate the degree of postural instability. Healthy subjects correct such perturbations with either one or two large steps, or without taking any steps, hinging rapidly at the hips while swinging the arms forward as a counterweight. In patients with balance impairment, balance correcting steps are often too small, forcing patients to take more than two steps. Taking three or more steps is generally considered to be abnormal, and taking more than five steps is regarded as being clearly abnormal. Markedly affected patients continue to step backward without ever regaining their balance and must be caught by the examiner (this would be called true retropulsion). Even more severely affected patients fail to correct entirely, and fall backward like a pushed toy soldier, without taking any corrective steps. Evidence: TAS. Frequency: Very frequent (HP:0040281). (ORPHA:683)
- Unsteady gait (HP:0002317). Evidence: TAS. Frequency: Very frequent (HP:0040281). (ORPHA:683)
- Falls (HP:0002527). Evidence: TAS. Frequency: Very frequent (HP:0040281). (ORPHA:683)
- Neuronal loss in central nervous system (HP:0002529). Evidence: TAS. Frequency: Very frequent (HP:0040281). (ORPHA:683)
- Abnormal synaptic transmission (HP:0012535): An anomaly in the communication from a neuron to a target across a synapse. This is a four step process, comprising (i) synthesis and storage of neurotransmitters; (ii) neurotransmitter release; (iii) activation of postsynaptic receptors by the neurotransmitter; and (iv) inactivation of the neurotransmitter. Thus, this term is defined as an anomaly of neurotransmitter metabolic process. Evidence: TAS. Frequency: Very frequent (HP:0040281). (ORPHA:683)
- Impulsivity (HP:0100710): Acting on the spur of the moment or on a momentary basis without consideration of outcomes; having difficulty establishing or following plans; experiencing a sense of urgency and engaging in behavior that is uninhibited, cannot be inhibited, and is uncontrolled. The possibility of repression is inconceivable. Evidence: TAS. Frequency: Very frequent (HP:0040281). (ORPHA:683)
- Visual impairment (HP:0000505): Visual impairment (or vision impairment) is vision loss (of a person) to such a degree as to qualify as an additional support need through a significant limitation of visual capability resulting from either disease, trauma, or congenital or degenerative conditions that cannot be corrected by conventional means, such as refractive correction, medication, or surgery. Evidence: TAS. Frequency: Frequent (HP:0040282). (ORPHA:683)
- Vertical supranuclear gaze palsy (HP:0000511): A supranuclear gaze palsy is an inability to look in a vertical direction as a result of cerebral impairment. There is a loss of the voluntary aspect of eye movements, but, as the brainstem is still intact, all the reflex conjugate eye movements are normal. Evidence: TAS. Frequency: Frequent (HP:0040282). (ORPHA:683)
- Slow saccadic eye movements (HP:0000514): An abnormally slow velocity of the saccadic eye movements. Evidence: TAS. Frequency: Frequent (HP:0040282). (ORPHA:683)
- Blepharospasm (HP:0000643): A focal dystonia that affects the muscles of the eyelids and brow, associated with involuntary recurrent spasm of both eyelids. Evidence: TAS. Frequency: Frequent (HP:0040282). (ORPHA:683)
- Emotional lability (HP:0000712): Unstable emotional experiences and frequent mood changes; emotions that are easily aroused, intense, and/or disproportionate to events and circumstances. Evidence: TAS. Frequency: Frequent (HP:0040282). (ORPHA:683)
- Depression (HP:0000716): Frequently experiencing feelings of being down, miserable, and/or hopeless; struggling to recover from these moods; having a pessimistic outlook on the future; feeling a pervasive sense of shame; having a low self-worth; experiencing thoughts of suicide and engaging in suicidal behavior. Evidence: TAS. Frequency: Frequent (HP:0040282). (ORPHA:683)
- Irritability (HP:0000737): An emotional state characterized by negative feelings of heightened frustration, annoyance, or feeling upset, often triggered by internal factors (e.g., fatigue, hunger, unfulfilled desires) or external factors (e.g., social or environmental challenges). Irritability may be unpredictable, and is accompanied by a lowered threshold for emotional reactivity and observable features (speech, facial expressions, or psychomotor activity). Evidence: TAS. Frequency: Frequent (HP:0040282). (ORPHA:683)
- Apathy (HP:0000741): Apathy is a quantitative reduction of interest, motivation and the initiation and persistence of goal-directed behavior, where often the accompanying emotions, thoughts, and social interactions are also diminished. The individual is typically non-reactive to provocations, positive or negative, and appears to not care. Distinguished from lethargy which involves lack of physical or mental energy. Evidence: TAS. Frequency: Frequent (HP:0040282). (ORPHA:683)
- Delayed speech and language development (HP:0000750): A degree of language development that is significantly below the norm for a child of a specified age. Evidence: TAS. Frequency: Frequent (HP:0040282). (ORPHA:683)
- Dysarthria (HP:0001260): Dysarthric speech is a general description referring to a neurological speech disorder characterized by poor articulation. Depending on the involved neurological structures, dysarthria may be further classified as spastic, flaccid, ataxic, hyperkinetic and hypokinetic, or mixed. Evidence: TAS. Frequency: Frequent (HP:0040282). (ORPHA:683)
- Dystonia (HP:0001332): An abnormally increased muscular tone that causes fixed abnormal postures. There is a slow, intermittent twisting motion that leads to exaggerated turning and posture of the extremities and trunk. Evidence: TAS. Frequency: Frequent (HP:0040282). (ORPHA:683)
- Bradykinesia (HP:0002067): Bradykinesia literally means slow movement, and is used clinically to denote a slowness in the execution of movement (in contrast to hypokinesia, which is used to refer to slowness in the initiation of movement). Evidence: TAS. Frequency: Frequent (HP:0040282). (ORPHA:683)
- Cerebral cortical atrophy (HP:0002120): Atrophy of the cortex of the cerebrum. Evidence: TAS. Frequency: Frequent (HP:0040282). (ORPHA:683)
- Gliosis (HP:0002171): Gliosis is the focal proliferation of glial cells in the central nervous system. Evidence: TAS. Frequency: Frequent (HP:0040282). (ORPHA:683)
- Pseudobulbar signs (HP:0002200): Pseudobulbar signs result from injury to an upper motor neuron lesion to the corticobulbar pathways in the pyramidal tract. Patients have difficulty chewing, swallowing and demonstrate slurred speech (often initial presentation) as well as abnormal behavioral symptoms such as inappropriate emotional outbursts of uncontrolled laughter or weeping etc. Evidence: TAS. Frequency: Frequent (HP:0040282). (ORPHA:683)
- Vertigo (HP:0002321): An abnormal sensation of spinning while the body is actually stationary. Evidence: TAS. Frequency: Frequent (HP:0040282). (ORPHA:683)
- Memory impairment (HP:0002354): An impairment of memory as manifested by a reduced ability to remember things such as dates and names, and increased forgetfulness. Evidence: TAS. Frequency: Frequent (HP:0040282). (ORPHA:683)
- Aphasia (HP:0002381): An acquired language impairment of some or all of the abilities to produce or comprehend speech and to read or write. Evidence: TAS. Frequency: Frequent (HP:0040282). (ORPHA:683)
- Cognitive impairment (HP:0100543): Abnormal cognition is characterized by deficits in thinking, reasoning, or remembering. Evidence: TAS. Frequency: Frequent (HP:0040282). (ORPHA:683)
- Abnormality of eye movement (HP:0000496): An abnormality in voluntary or involuntary eye movements or their control. Evidence: TAS. Frequency: Occasional (HP:0040283). (ORPHA:683)
- Dementia (HP:0000726): A loss of global cognitive ability of sufficient amount to interfere with normal social or occupational function. Dementia represents a loss of previously present cognitive abilities, generally in adults, and can affect memory, thinking, language, judgment, and behavior. Evidence: TAS. Frequency: Occasional (HP:0040283). (ORPHA:683)
- Tremor (HP:0001337): An unintentional, oscillating to-and-fro muscle movement about a joint axis. Evidence: TAS. Frequency: Occasional (HP:0040283). (ORPHA:683)
- Rigidity (HP:0002063): Continuous involuntary sustained muscle contraction. When an affected muscle is passively stretched, the degree of resistance remains constant regardless of the rate at which the muscle is stretched. This feature helps to distinguish rigidity from muscle spasticity. Evidence: TAS. Frequency: Occasional (HP:0040283). (ORPHA:683)
These phenotypes are associated with the disease Progressive supranuclear palsy (ORPHA:683).